Phenotypes associated with the disease Inverted duplicated chromosome 15 syndrome (ORPHA:3306):
- Posteriorly rotated ears (HP:0000358): A type of abnormal location of the ears in which the position of the ears is characterized by posterior rotation (the superior part of the ears is rotated towards the back of the head, and the inferior part of the ears towards the front). Evidence: TAS. Frequency: Occasional (HP:0040283). (ORPHA:3306)
- Autistic behavior (HP:0000729): Persistent deficits in social interaction and communication and interaction as well as a markedly restricted repertoire of activity and interest as well as repetitive patterns of behavior. Evidence: TAS. Frequency: Very frequent (HP:0040281). (ORPHA:3306)
- Generalized hypotonia (HP:0001290): Generalized muscular hypotonia (abnormally low muscle tone). Evidence: TAS. Frequency: Very frequent (HP:0040281). (ORPHA:3306)
- Joint hypermobility (HP:0001382): The capability that a joint (or a group of joints) has to move, passively and/or actively, beyond normal limits along physiological axes. Evidence: TAS. Frequency: Very frequent (HP:0040281). (ORPHA:3306)
- Drooling (HP:0002307): Habitual flow of saliva out of the mouth. Evidence: TAS. Frequency: Very frequent (HP:0040281). (ORPHA:3306)
- Motor stereotypy (HP:0000733): Use of the same abnormal action in response to certain triggers or at random. They may be used as a way to regulate one's internal state but must otherwise have no apparent functional purpose. Evidence: TAS. Frequency: Frequent (HP:0040282). (ORPHA:3306)
- Hyperactivity (HP:0000752): Hyperactivity is a condition characterized by constant and unusually high levels of activity, even in situations where it is deemed inappropriate. Evidence: TAS. Frequency: Frequent (HP:0040282). (ORPHA:3306)
- Seizure (HP:0001250): A seizure is an intermittent abnormality of nervous system physiology characterized by a transient occurrence of signs and/or symptoms due to abnormal excessive or synchronous neuronal activity in the brain. Evidence: TAS. Frequency: Frequent (HP:0040282). (ORPHA:3306)
- Severe expressive language delay (HP:0006863): A severe delay in the acquisition of the ability to use language to communicate needs, wishes, or thoughts. Evidence: TAS. Frequency: Frequent (HP:0040282). (ORPHA:3306)
- Echolalia (HP:0010529): Echolalia is the automatic imitative repetition of sounds, words, or phrases in the absence of explicit awareness. The repeated words or phrases are typically odd or used in a non-social manner. These can be words or phrases that the affected individual has heard or invented. Evidence: TAS. Frequency: Frequent (HP:0040282). (ORPHA:3306)
- Severe receptive language delay (HP:0011352): A severe delay in the acquisition of the ability to understand the speech of others. Evidence: TAS. Frequency: Frequent (HP:0040282). (ORPHA:3306)
- Feeding difficulties (HP:0011968): Impaired ability to eat related to problems gathering food and getting ready to suck, chew, or swallow it. Evidence: TAS. Frequency: Frequent (HP:0040282). (ORPHA:3306)
- Self-biting (HP:0012169): Habitual biting of one's own body. Evidence: TAS. Frequency: Frequent (HP:0040282). (ORPHA:3306)
- Neurodevelopmental delay (HP:0012758): Neurodevelopmental delay (NDD) refers to delays in the maturation of the brain and central nervous system; infants and young children with NDD may experience delays in the development of one or more skills including gross motor abilities, fine-motor coordination, language abilities and ability to solve increasingly complex problems. Evidence: TAS. Frequency: Frequent (HP:0040282). (ORPHA:3306)
- Hypogonadism (HP:0000135): A decreased functionality of the gonad. Evidence: TAS. Frequency: Occasional (HP:0040283). (ORPHA:3306)
- High palate (HP:0000218): Height of the palate more than 2 SD above the mean (objective) or palatal height at the level of the first permanent molar more than twice the height of the teeth (subjective). Evidence: TAS. Frequency: Occasional (HP:0040283). (ORPHA:3306)
- Brachycephaly (HP:0000248): An abnormality of skull shape characterized by a decreased anterior-posterior diameter. That is, a cephalic index greater than 81%. Alternatively, an apparently shortened anteroposterior dimension (length) of the head compared to width. Evidence: TAS. Frequency: Occasional (HP:0040283). (ORPHA:3306)
- Microcephaly (HP:0000252): Head circumference below 2 standard deviations below the mean for age and gender. Evidence: TAS. Frequency: Occasional (HP:0040283). (ORPHA:3306)
- Epicanthus (HP:0000286): A fold of skin starting above the medial aspect of the upper eyelid and arching downward to cover, pass in front of and lateral to the medial canthus. Evidence: TAS. Frequency: Occasional (HP:0040283). (ORPHA:3306)
- Short philtrum (HP:0000322): Distance between nasal base and midline upper lip vermilion border more than 2 SD below the mean. Alternatively, an apparently decreased distance between nasal base and midline upper lip vermilion border. Evidence: TAS. Frequency: Occasional (HP:0040283). (ORPHA:3306)
- Broad nasal tip (HP:0000455): Increase in width of the nasal tip. Evidence: TAS. Frequency: Occasional (HP:0040283). (ORPHA:3306)
- Strabismus (HP:0000486): A misalignment of the eyes so that the visual axes deviate from bifoveal fixation. The classification of strabismus may be based on a number of features including the relative position of the eyes, whether the deviation is latent or manifest, intermittent or constant, concomitant or otherwise and according to the age of onset and the relevance of any associated refractive error. Evidence: TAS. Frequency: Occasional (HP:0040283). (ORPHA:3306)
- Deeply set eye (HP:0000490): An eye that is more deeply recessed into the plane of the face than is typical. Evidence: TAS. Frequency: Occasional (HP:0040283). (ORPHA:3306)
- Downslanted palpebral fissures (HP:0000494): The palpebral fissure inclination is more than two standard deviations below the mean. Evidence: TAS. Frequency: Occasional (HP:0040283). (ORPHA:3306)
- Synophrys (HP:0000664): Meeting of the medial eyebrows in the midline. Evidence: TAS. Frequency: Occasional (HP:0040283). (ORPHA:3306)
- Aggressive behavior (HP:0000718): Behavior or an act aimed at harming a person, animal, or physical property (e.g., acts of physical violence; shouting, swearing, and using harsh language; slashing someone's tires). Evidence: TAS. Frequency: Occasional (HP:0040283). (ORPHA:3306)
- Brachydactyly (HP:0001156): Digits that appear disproportionately short compared to the hand/foot. The word brachydactyly is used here to describe a series distinct patterns of shortened digits (brachydactyly types A-E). This is the sense used here. Evidence: TAS. Frequency: Occasional (HP:0040283). (ORPHA:3306)
- Growth delay (HP:0001510): A deficiency or slowing down of growth pre- and postnatally. Evidence: TAS. Frequency: Occasional (HP:0040283). (ORPHA:3306)
- Abnormal facial shape (HP:0001999): An abnormal morphology (form) of the face or its components. Evidence: TAS. Frequency: Occasional (HP:0040283). (ORPHA:3306)
- Clinodactyly of the 5th finger (HP:0004209): Clinodactyly refers to a bending or curvature of the fifth finger in the radial direction (i.e., towards the 4th finger). Evidence: TAS. Frequency: Occasional (HP:0040283). (ORPHA:3306)
- 2-3 toe syndactyly (HP:0004691): Syndactyly with fusion of toes two and three. Evidence: TAS. Frequency: Occasional (HP:0040283). (ORPHA:3306)
- Abnormal brain morphology (HP:0012443): A structural abnormality of the brain, which has as its parts the forebrain, midbrain, and hindbrain. Evidence: TAS. Frequency: Occasional (HP:0040283). (ORPHA:3306)
- Cryptorchidism (HP:0000028): Testis in inguinal canal. That is, absence of one or both testes from the scrotum owing to failure of the testis or testes to descend through the inguinal canal to the scrotum. Evidence: TAS. Frequency: Very rare (HP:0040284). (ORPHA:3306)
- Unilateral renal agenesis (HP:0000122): A unilateral form of agenesis of the kidney. Evidence: TAS. Frequency: Very rare (HP:0040284). (ORPHA:3306)
- Gonadal dysgenesis (HP:0000133): Gonadal dysgenesis is the name given to any of a multitude of conditions that can cause impaired development of the gonads, i.e., the testes or ovaries, or to the related phenotypic features. The term is to be avoided if possible for new annotations, and more specific terms should be chosen. Evidence: TAS. Frequency: Very rare (HP:0040284). (ORPHA:3306)
- Precocious puberty (HP:0000826): The onset of secondary sexual characteristics before a normal age. Although it is difficult to define normal age ranges because of the marked variation with which puberty begins in normal children, precocious puberty can be defined as the onset of puberty before the age of 8 years in girls or 9 years in boys. Evidence: TAS. Frequency: Very rare (HP:0040284). (ORPHA:3306)
- Ventricular septal defect (HP:0001629): A hole between the two bottom chambers (ventricles) of the heart. The defect is centered around the most superior aspect of the ventricular septum. Evidence: TAS. Frequency: Very rare (HP:0040284). (ORPHA:3306)
- Tetralogy of Fallot (HP:0001636): A congenital cardiac malformation comprising pulmonary stenosis, overriding aorta, ventricular septum defect, and right ventricular hypertrophy. The diagnosis of TOF is made if at least three of the four above mentioned features are present. Evidence: TAS. Frequency: Very rare (HP:0040284). (ORPHA:3306)
- Talipes equinovarus (HP:0001762): Talipes equinovarus (also called clubfoot) typically has four main components: inversion and adduction of the forefoot; inversion of the heel and hindfoot; equinus (limitation of extension) of the ankle and subtalar joint; and internal rotation of the leg. Evidence: TAS. Frequency: Very rare (HP:0040284). (ORPHA:3306)
- Hernia (HP:0100790). Evidence: TAS. Frequency: Very rare (HP:0040284). (ORPHA:3306)
Not associated with this disease:
- Frontal bossing (HP:0002007): Bilateral bulging of the lateral frontal bone prominences with relative sparing of the midline. Evidence: TAS. (ORPHA:3306)